- Microcephaly (HP:0000252): Head circumference below 2 standard deviations below the mean for age and gender. Evidence: TAS. Frequency: Occasional (HP:0040283). (ORPHA:276413)
- Macrocephaly (HP:0000256): Occipitofrontal (head) circumference greater than 97th centile compared to appropriate, age matched, sex-matched normal standards. Alternatively, a apparently increased size of the cranium. Evidence: TAS. Frequency: Very frequent (HP:0040281). (ORPHA:276413)
- Epicanthus (HP:0000286): A fold of skin starting above the medial aspect of the upper eyelid and arching downward to cover, pass in front of and lateral to the medial canthus. Evidence: TAS. Frequency: Occasional (HP:0040283). (ORPHA:276413)
- Microretrognathia (HP:0000308): A form of developmental hypoplasia of the mandible in which the mandible is mislocalised posteriorly. Evidence: TAS. Frequency: Occasional (HP:0040283). (ORPHA:276413)
- Hypertelorism (HP:0000316): Interpupillary distance more than 2 SD above the mean (alternatively, the appearance of an increased interpupillary distance or widely spaced eyes). Evidence: TAS. Frequency: Frequent (HP:0040282). (ORPHA:276413)
- Low-set ears (HP:0000369): Upper insertion of the ear to the scalp below an imaginary horizontal line drawn between the inner canthi of the eye and extending posteriorly to the ear. Evidence: TAS. Frequency: Frequent (HP:0040282). (ORPHA:276413)
- Anteverted nares (HP:0000463): Anteriorly-facing nostrils viewed with the head in the Frankfurt horizontal and the eyes of the observer level with the eyes of the subject. This gives the appearance of an upturned nose (upturned nasal tip). Evidence: TAS. Frequency: Occasional (HP:0040283). (ORPHA:276413)
- Downslanted palpebral fissures (HP:0000494): The palpebral fissure inclination is more than two standard deviations below the mean. Evidence: TAS. Frequency: Occasional (HP:0040283). (ORPHA:276413)
- Upslanted palpebral fissure (HP:0000582): The palpebral fissure inclination is more than two standard deviations above the mean for age (objective); or, the inclination of the palpebral fissure is greater than typical for age. Evidence: TAS. Frequency: Occasional (HP:0040283). (ORPHA:276413)
- Hypotelorism (HP:0000601): Interpupillary distance less than 2 SD below the mean (alternatively, the appearance of an decreased interpupillary distance or closely spaced eyes). Evidence: TAS. Frequency: Occasional (HP:0040283). (ORPHA:276413)
- Autism (HP:0000717): Autism is a neurodevelopmental disorder characterized by impaired social interaction and communication, and by restricted and repetitive behavior. Autism begins in childhood. It is marked by the presence of markedly abnormal or impaired development in social interaction and communication and a markedly restricted repertoire of activity and interest. Manifestations of the disorder vary greatly depending on the developmental level and chronological age of the individual (DSM-IV). Evidence: TAS. Frequency: Occasional (HP:0040283). (ORPHA:276413)
- Arachnodactyly (HP:0001166): Abnormally long and slender fingers (spider fingers). Evidence: TAS. Frequency: Occasional (HP:0040283). (ORPHA:276413)
- Intellectual disability (HP:0001249): The term intellectual disability or intellectual developmental disorder is used to describe significantly sub-average intellectual and adaptive functioning based on clinical assessment and as measured by individually administered, appropriately normed, standardized and validated tests of intellectual functioning and adaptive behavior, with onset during the developmental period from infancy through adolescence. Evidence: TAS. Frequency: Very frequent (HP:0040281). (ORPHA:276413)
- Seizure (HP:0001250): A seizure is an intermittent abnormality of nervous system physiology characterized by a transient occurrence of signs and/or symptoms due to abnormal excessive or synchronous neuronal activity in the brain. Evidence: TAS. Frequency: Occasional (HP:0040283). (ORPHA:276413)
- Global developmental delay (HP:0001263): A delay in the achievement of motor or mental milestones in the domains of development of a child, including motor skills, speech and language, cognitive skills, and social and emotional skills. This term should only be used to describe children younger than five years of age. Evidence: TAS. Frequency: Very frequent (HP:0040281). (ORPHA:276413)
- Cerebellar hypoplasia (HP:0001321): Cerebellar hypoplasia is a descriptive term implying a cerebellum with a reduced volume, but a normal shape and is stable over time. Evidence: TAS. Frequency: Occasional (HP:0040283). (ORPHA:276413)
- Failure to thrive (HP:0001508): Failure to thrive (FTT) refers to a child whose physical growth is substantially below the norm. Evidence: TAS. Frequency: Occasional (HP:0040283). (ORPHA:276413)
- Patent ductus arteriosus (HP:0001643): In utero, the ductus arteriosus (DA) serves to divert ventricular output away from the lungs and toward the placenta by connecting the main pulmonary artery to the descending aorta. A patent ductus arteriosus (PDA) in the first 3 days of life is a physiologic shunt in healthy term and preterm newborn infants, and normally is substantially closed within about 24 hours after bith and completely closed after about three weeks. Failure of physiologcal closure is referred to a persistent or patent ductus arteriosus (PDA). Depending on the degree of left-to-right shunting, PDA can have clinical consequences. Evidence: TAS. Frequency: Occasional (HP:0040283). (ORPHA:276413)
- Tricuspid valve prolapse (HP:0001704): One or more of the leaflets (cusps) of the tricuspid valve bulges back into the right atrium upon contraction of the right ventricle. Evidence: TAS. Frequency: Occasional (HP:0040283). (ORPHA:276413)
- Talipes (HP:0001883): A deformity of foot and ankle that has different subtypes that are talipes equinovarus, talipes equinovalgus, talipes calcaneovarus and talipes calcaneovalgus. Evidence: TAS. Frequency: Occasional (HP:0040283). (ORPHA:276413)
- Frontal bossing (HP:0002007): Bilateral bulging of the lateral frontal bone prominences with relative sparing of the midline. Evidence: TAS. Frequency: Occasional (HP:0040283). (ORPHA:276413)
- Chiari malformation (HP:0002308): Chiari malformation consists of a downward displacement of the cerebellar tonsils and the medulla through the foramen magnum, sometimes causing hydrocephalus as a result of obstruction of CSF outflow. Evidence: TAS. Frequency: Occasional (HP:0040283). (ORPHA:276413)
- Language impairment (HP:0002463): Language impairment is a deficit in comprehension or production of language that includes reduced vocabulary, limited sentence structure, or impairments in written or spoken communication. Language abilities are substantially and quantifiably below age expectations. Evidence: TAS. Frequency: Very frequent (HP:0040281). (ORPHA:276413)
- Depressed nasal bridge (HP:0005280): Posterior positioning of the nasal root in relation to the overall facial profile for age. Evidence: TAS. Frequency: Frequent (HP:0040282). (ORPHA:276413)
- Atrioventricular canal defect (HP:0006695): A defect of the atrioventricular septum of the heart. Evidence: TAS. Frequency: Occasional (HP:0040283). (ORPHA:276413)
- Attention deficit hyperactivity disorder (HP:0007018): Attention deficit hyperactivity disorder (ADHD) manifests at age 2-3 years or by first grade at the latest. The main symptoms are distractibility, impulsivity, hyperactivity, and often trouble organizing tasks and projects, difficulty going to sleep, and social problems from being aggressive, loud, or impatient. Evidence: TAS. Frequency: Occasional (HP:0040283). (ORPHA:276413)
- Curved middle phalanx of the 4th toe (HP:0100444): A deviation from the normal straight form of the middle phalanx of the fourth toe. Evidence: TAS. Frequency: Occasional (HP:0040283). (ORPHA:276413)
- Breast aplasia (HP:0100783): Failure to develop and congenital absence of the breast. Evidence: TAS. Frequency: Occasional (HP:0040283). (ORPHA:276413)
- Intestinal polyposis (HP:0200008): The presence of multiple polyps in the intestine. Evidence: TAS. Frequency: Occasional (HP:0040283). (ORPHA:276413)
- Joint hypermobility (HP:0001382): The capability that a joint (or a group of joints) has to move, passively and/or actively, beyond normal limits along physiological axes. Evidence: TAS. Frequency: Occasional (HP:0040283). (ORPHA:276413)
These phenotypes are associated with the disease 10q22.3q23.3 microdeletion syndrome (ORPHA:276413).